Phenotypes associated with the disease Meningococcal meningitis (ORPHA:33475):
- Fever (HP:0001945): Body temperature elevated above the normal range. Evidence: TAS. Frequency: Very frequent (HP:0040281). (ORPHA:33475)
- Increased CSF protein concentration (HP:0002922): Increased concentration of protein in the cerebrospinal fluid. Evidence: TAS. Frequency: Very frequent (HP:0040281). (ORPHA:33475)
- Hypoglycorrhachia (HP:0011972): Abnormally low glucose concentration in the cerebrospinal fluid. Evidence: TAS. Frequency: Very frequent (HP:0040281). (ORPHA:33475)
- CSF pleocytosis (HP:0012229): An increased white blood cell count in the cerebrospinal fluid. Evidence: TAS. Frequency: Very frequent (HP:0040281). (ORPHA:33475)
- Stiff neck (HP:0025258): A sensation of tightness in the neck when attempting to move it, especially after a period of inactivity. Neck stiffness often involves soreness and difficulty moving the neck, especially when trying to turn the head to the side. Evidence: TAS. Frequency: Very frequent (HP:0040281). (ORPHA:33475)
- Nuchal rigidity (HP:0031179): Resistance of the extensor muscles of the neck to being bent forwards (i.e., impaired neck flexion) as a result of muscle spasm of the extensor muscles of the neck. Nuchal rigidity is not a fixed rigidity. Nuchal rigidity has been used as a bedside test for meningism, although its sensitivity for this purpose has been debated. Evidence: TAS. Frequency: Very frequent (HP:0040281). (ORPHA:33475)
- Photophobia (HP:0000613): Excessive sensitivity to light with the sensation of discomfort or pain in the eyes due to exposure to bright light. Evidence: TAS. Frequency: Frequent (HP:0040282). (ORPHA:33475)
- Petechiae (HP:0000967): Petechiae are pinpoint-sized reddish/purple spots, resembling a rash, that appear just under the skin or a mucous membrane when capillaries have ruptured and some superficial bleeding into the skin has happened. This term refers to an abnormally increased susceptibility to developing petechiae. Evidence: TAS. Frequency: Frequent (HP:0040282). (ORPHA:33475)
- Skin rash (HP:0000988): A red eruption of the skin. Evidence: TAS. Frequency: Frequent (HP:0040282). (ORPHA:33475)
- Anorexia (HP:0002039): Lack of desire to eat (loss of appetite). Evidence: TAS. Frequency: Frequent (HP:0040282). (ORPHA:33475)
- Headache (HP:0002315): Cephalgia, or pain sensed in various parts of the head, not confined to the area of distribution of any nerve. Evidence: TAS. Frequency: Frequent (HP:0040282). (ORPHA:33475)
- Projectile vomiting (HP:0002587): Vomiting that ejects the gastric contents with great force. Evidence: TAS. Frequency: Frequent (HP:0040282). (ORPHA:33475)
- Reduced consciousness (HP:0004372): Abnormally diminished level of attention, responsiveness, or wakefulness. Evidence: TAS. Frequency: Frequent (HP:0040282). (ORPHA:33475)
- Elevated circulating C-reactive protein concentration (HP:0011227): The concentration of C-reactive protein in the blood circulation is above the upper limit of normal. Evidence: TAS. Frequency: Frequent (HP:0040282). (ORPHA:33475)
- Sepsis (HP:0100806): Sepsis is defined as life-threatening organ dysfunction caused by a dysregulated host response to infection. Evidence: TAS. Frequency: Frequent (HP:0040282). (ORPHA:33475)
- Renal insufficiency (HP:0000083): A reduction in the level of performance of the kidneys in areas of function comprising the concentration of urine, removal of wastes, the maintenance of electrolyte balance, homeostasis of blood pressure, and calcium metabolism. Evidence: TAS. Frequency: Occasional (HP:0040283). (ORPHA:33475)
- Abnormal anterior fontanelle morphology (HP:0000236): An abnormality of the anterior fontanelle, i.e., the cranial fontanelle that is located at the intersection of the coronal and sagittal sutures. Evidence: TAS. Frequency: Occasional (HP:0040283). (ORPHA:33475)
- Hearing impairment (HP:0000365): A decreased magnitude of the sensory perception of sound. Evidence: TAS. Frequency: Occasional (HP:0040283). (ORPHA:33475)
- Irritability (HP:0000737): An emotional state characterized by negative feelings of heightened frustration, annoyance, or feeling upset, often triggered by internal factors (e.g., fatigue, hunger, unfulfilled desires) or external factors (e.g., social or environmental challenges). Irritability may be unpredictable, and is accompanied by a lowered threshold for emotional reactivity and observable features (speech, facial expressions, or psychomotor activity). Evidence: TAS. Frequency: Occasional (HP:0040283). (ORPHA:33475)
- Purpura (HP:0000979): Purpura (from Latin: purpura, meaning purple) is the appearance of red or purple discolorations on the skin that do not blanch on applying pressure. They are caused by bleeding underneath the skin. This term refers to an abnormally increased susceptibility to developing purpura. Purpura are larger than petechiae. Evidence: TAS. Frequency: Occasional (HP:0040283). (ORPHA:33475)
- Papilledema (HP:0001085): Papilledema refers to edema (swelling) of the optic disc secondary to any factor which increases cerebral spinal fluid pressure. Evidence: TAS. Frequency: Occasional (HP:0040283). (ORPHA:33475)
- Seizure (HP:0001250): A seizure is an intermittent abnormality of nervous system physiology characterized by a transient occurrence of signs and/or symptoms due to abnormal excessive or synchronous neuronal activity in the brain. Evidence: TAS. Frequency: Occasional (HP:0040283). (ORPHA:33475)
- Lethargy (HP:0001254): A state of fatigue, either physical or mental slowness and sluggishness, with difficulties in initiating or performing simple tasks. Distinguished from apathy which implies indifference and a lack of desire or interest in the task. A person with lethargy may have the desire, but not the energy to engage in personal or socially relevant tasks. Evidence: TAS. Frequency: Occasional (HP:0040283). (ORPHA:33475)
- Drowsiness (HP:0002329): Abnormal feeling of sleepiness or difficulty staying awake. Evidence: TAS. Frequency: Occasional (HP:0040283). (ORPHA:33475)
- Increased intracranial pressure (HP:0002516): An increase of the pressure inside the cranium (skull) and thereby in the brain tissue and cerebrospinal fluid. Evidence: TAS. Frequency: Occasional (HP:0040283). (ORPHA:33475)
- Hypotension (HP:0002615): Low Blood Pressure, vascular hypotension. Evidence: TAS. Frequency: Occasional (HP:0040283). (ORPHA:33475)
- Paresthesia (HP:0003401): Abnormal sensations such as tingling, pricking, or numbness of the skin with no apparent physical cause. Evidence: TAS. Frequency: Occasional (HP:0040283). (ORPHA:33475)
- Increased circulating procalcitonin concentration (HP:0032308): An elevated concentration of procalcitonin in the blood circulation. Evidence: TAS. Frequency: Occasional (HP:0040283). (ORPHA:33475)
- Stroke (HP:0001297): Sudden impairment of blood flow to a part of the brain due to occlusion or rupture of an artery to the brain. Evidence: TAS. Frequency: Very rare (HP:0040284). (ORPHA:33475)
- Hypothermia (HP:0002045): Reduced body temperature due to failed thermoregulation. Evidence: TAS. Frequency: Very rare (HP:0040284). (ORPHA:33475)
- Infectious encephalitis (HP:0002383): A disorder of the brain caused by an infectious agent that presents with fever, headache, and an altered level of consciousness. There may also be focal or multifocal neurologic deficits, and focal or generalized seizure activity. Evidence: TAS. Frequency: Very rare (HP:0040284). (ORPHA:33475)
- Neonatal respiratory distress (HP:0002643): Respiratory difficulty as newborn. Evidence: TAS. Frequency: Very rare (HP:0040284). (ORPHA:33475)
- Cranial nerve paralysis (HP:0006824). Evidence: TAS. Frequency: Very rare (HP:0040284). (ORPHA:33475)
- Acute disseminated intravascular coagulation (HP:0011880): An acute form of disseminated intravascular coagulation. Acute DIC can occur following sudden exposure of blood to procoagulants, with the compensatory hemostatic mechanisms becoming overwhelmed. Evidence: TAS. Frequency: Very rare (HP:0040284). (ORPHA:33475)
- Shock (HP:0031273): The state in which profound and widespread reduction of effective tissue perfusion leads first to reversible, and then if prolonged, to irreversible cellular injury. Evidence: TAS. Frequency: Very rare (HP:0040284). (ORPHA:33475)